Phenotypes associated with the disease neuronal ceroid lipofuscinosis 3 (OMIM:204200):
- Bilateral tonic-clonic seizure (HP:0002069): A bilateral tonic-clonic seizure is a seizure defined by a tonic (bilateral increased tone, lasting seconds to minutes) and then a clonic (bilateral sustained rhythmic jerking) phase. Evidence: PCS. Frequency: 1/1. (PMID:7887420)
- Seizure (HP:0001250): A seizure is an intermittent abnormality of nervous system physiology characterized by a transient occurrence of signs and/or symptoms due to abnormal excessive or synchronous neuronal activity in the brain. Evidence: IEA. (OMIM:204200)
- Concentric hypertrophic cardiomyopathy (HP:0005157): Hypertrophic cardiomyopathy with an symmetrical and concentric pattern of hypertrophy. Evidence: TAS. (OMIM:204200)
- Psychomotor deterioration (HP:0002361): Loss of previously present mental and motor abilities. Evidence: PCS. Frequency: 1/1. (PMID:7887420)
- Cataract (HP:0000518): A cataract is an opacity or clouding that develops in the crystalline lens of the eye or in its capsule. Evidence: IEA. (OMIM:204200)
- Blindness (HP:0000618): Blindness is the condition of lacking visual perception defined as a profound reduction in visual perception. On the 6m visual acuity scale, blindness is defined as less than 3/60. On the 20ft visual acuity scale, blindness is defined as less than 20/400. On the decimal visual acuity scale, blindness is defined as less than 0.05. Blindness is typically characterized by a visual field of no greater than 10 degrees in radius around central fixation. Evidence: IEA. (OMIM:204200)
- Anxiety (HP:0000739): Intense feelings of nervousness, tension, or panic often arise in response to interpersonal stresses. There is worry about the negative effects of past unpleasant experiences and future negative possibilities. Individuals may feel fearful, apprehensive, or threatened by uncertainty, and they may also have fears of falling apart or losing control. Evidence: TAS. (OMIM:204200)
- Vacuolated lymphocytes (HP:0001922): The presence of clear, sharply defined vacuoles in the lymphocyte cytoplasm. Evidence: PCS. Frequency: 1/1. (PMID:7887420)
- Reduced visual acuity (HP:0007663). Evidence: PCS. Frequency: 1/1. (PMID:7887420)
- Fingerprint intracellular accumulation of autofluorescent lipopigment storage material (HP:0003208): An intracellular accumulation of autofluorescent lipopigment storage material in a trabecular or fingerprint-like pattern. Evidence: PCS. Frequency: 1/1. (PMID:7887420)
- Rod-cone dystrophy (HP:0000510): An inherited retinal disease subtype in which the rod photoreceptors appear to be more severely affected than the cone photoreceptors. Typical presentation is with nyctalopia (due to rod dysfunction) followed by loss of mid-peripheral field of vision, which gradually extends and leaves many patients with a small central island of vision due to the preservation of macular cones. Evidence: IEA. (OMIM:204200)
- Intellectual disability (HP:0001249): The term intellectual disability or intellectual developmental disorder is used to describe significantly sub-average intellectual and adaptive functioning based on clinical assessment and as measured by individually administered, appropriately normed, standardized and validated tests of intellectual functioning and adaptive behavior, with onset during the developmental period from infancy through adolescence. Evidence: IEA. (OMIM:204200)
- Curvilinear intracellular accumulation of autofluorescent lipopigment storage material (HP:0003205): An intracellular accumulation of autofluorescent lipopigment storage material in a curved pattern. Evidence: IEA. (OMIM:204200)
- Undetectable electroretinogram (HP:0000550): Lack of any response to stimulation upon electroretinography. Evidence: IEA. (OMIM:204200)
- Juvenile onset (HP:0003621): Onset of signs or symptoms of disease between the age of 5 and 15 years. Evidence: PCS. Frequency: 1/1. (PMID:7887420)
- Cerebral atrophy (HP:0002059): Atrophy (wasting, decrease in size of cells or tissue) affecting the cerebrum. Evidence: IEA. (OMIM:204200)
- Parkinsonism (HP:0001300): Characteristic neurologic anomaly resulting from degeneration of dopamine-generating cells in the substantia nigra, a region of the midbrain, characterized clinically by shaking, rigidity, slowness of movement and difficulty with walking and gait. Evidence: PCS. Frequency: 1/1. (PMID:7887420)
- Increased extraneuronal autofluorescent lipopigment (HP:0003463): Lipofuscin, a generic term applied to autofluorescent lipopigment, is a mixture of protein and lipid that accumulates in most aging cells, particularly those involved in high lipid turnover (e.g., the adrenal medulla) or phagocytosis of other cell types (e g., the retinal pigment epithelium or RPE; macrophage). This term pertains if there is an increase in the extraneuronal accumulation of lipofuscin (also known as autofluorescent lipoprotein) more than expected for the age of the patient. Evidence: IEA. (OMIM:204200)
- Dysarthria (HP:0001260): Dysarthric speech is a general description referring to a neurological speech disorder characterized by poor articulation. Depending on the involved neurological structures, dysarthria may be further classified as spastic, flaccid, ataxic, hyperkinetic and hypokinetic, or mixed. Evidence: IEA. (OMIM:204200)
- Increased neuronal autofluorescent lipopigment (HP:0002074): Lipofuscin, a generic term applied to autofluorescent lipopigment, is a mixture of protein and lipid that accumulates in most aging cells, particularly those involved in high lipid turnover (e.g., the adrenal medulla) or phagocytosis of other cell types (e g., the retinal pigment epithelium or RPE; macrophage). This term pertains if there is an increase in the neuronal accumulation of lipofuscin (also known as autofluorescent lipoprotein) more than expected for the age of the patient. Evidence: IEA. (OMIM:204200)
- Abnormality of extrapyramidal motor function (HP:0002071): A neurological condition related to lesions of the basal ganglia leading to typical abnormalities including akinesia (inability to initiate changes in activity and perform volitional movements rapidly and easily), muscular rigidity (continuous contraction of muscles with constant resistance to passive movement), chorea (widespread arrhythmic movements of a forcible, rapid, jerky, and restless nature), athetosis (inability to sustain the muscles of the fingers, toes, or other group of muscles in a fixed position), and akathisia (inability to remain motionless). Evidence: IEA. (OMIM:204200)
- Psychosis (HP:0000709): A condition characterized by changes in personality and thought patterns, often accompanied by hallucinations and delusional beliefs, is known as psychosis. Evidence: IEA. (OMIM:204200)
- Progressive visual loss (HP:0000529): A reduction of previously attained ability to see. Evidence: PCS. Frequency: 1/1. (PMID:7887420)
- Dementia (HP:0000726): A loss of global cognitive ability of sufficient amount to interfere with normal social or occupational function. Dementia represents a loss of previously present cognitive abilities, generally in adults, and can affect memory, thinking, language, judgment, and behavior. Evidence: IEA. (OMIM:204200)
- Macular degeneration (HP:0000608): A nonspecific term denoting degeneration of the retinal pigment epithelium and/or retinal photoreceptor cells of the macula lutea. Evidence: IEA. (OMIM:204200)
- Abnormal cerebellum morphology (HP:0001317): Any structural abnormality of the cerebellum. Evidence: IEA. (OMIM:204200)
- Retinal degeneration (HP:0000546): A nonspecific term denoting progressive loss of the retinal pigment epithelium (RPE) and/or neurosensory retinal cells. Evidence: PCS. Frequency: 1/1. (PMID:7887420)
- Autosomal recessive inheritance (HP:0000007): A mode of inheritance that is observed for traits related to a gene encoded on one of the autosomes (i.e., the human chromosomes 1-22) in which a trait manifests in individuals with two pathogenic alleles, either homozygotes (two copies of the same mutant allele) or compound heterozygotes (whereby each copy of a gene has a distinct mutant allele). Evidence: PCS. (PMID:7553855)
- Optic atrophy (HP:0000648): Atrophy of the optic nerve. Optic atrophy results from the death of the retinal ganglion cell axons that comprise the optic nerve and manifesting as a pale optic nerve on fundoscopy. Evidence: IEA. (OMIM:204200)
- Loss of ambulation (HP:0002505): Inability to walk in a person who previous had the ability to walk. Evidence: PCS. Frequency: 1/1. (PMID:7887420)
- Glaucoma (HP:0000501): Glaucoma refers loss of retinal ganglion cells in a characteristic pattern of optic neuropathy usually associated with increased intraocular pressure. Evidence: IEA. (OMIM:204200)
- Myoclonus (HP:0001336): Very brief, involuntary random muscular contractions occurring at rest, in response to sensory stimuli, or accompanying voluntary movements. Evidence: IEA. (OMIM:204200)